- Ureter duplex (HP:0012572): A complete duplication of the ureter, where the duplicated ureters have separate insertions into the bladder. Evidence: PCS. Frequency: 2/4. (PMID:20960469)
- Recurrent urinary tract infections (HP:0000010): Repeated infections of the urinary tract. Evidence: PCS. Frequency: 1/4. (PMID:20960469)
- Polyhydramnios (HP:0001561): The presence of excess amniotic fluid in the uterus during pregnancy. Evidence: PCS. Frequency: 1/4. (PMID:20960469)
- Grade III vesicoureteral reflux (HP:0033737): Vesicoureteral reflux with dilatation of the collecting system. Evidence: PCS. Frequency: 1/4. (PMID:20960469)
- Hydroureter (HP:0000072): The distention of the ureter with urine. Evidence: PCS. Frequency: 1/4. (PMID:20960469)
- Ureteropelvic junction obstruction (HP:0000074): Blockage of urine flow from the renal pelvis to the proximal ureter. Evidence: PCS. Frequency: 1/4. (PMID:20960469)
- Chronic constipation (HP:0012450): Constipation for longer than three months with fewer than 3 bowel movements per week, straining, lumpy or hard stools, and a sensation of anorectal obstruction or incomplete defecation. Evidence: PCS. Frequency: 2/4. (PMID:20960469)
- Grade IV vesicoureteral reflux (HP:0033741): Vesicoureteral reflux with more-extensive dilation with blunting of the calyces and tortuosity of the ureter. Evidence: PCS. Frequency: 1/4. (PMID:20960469)
- Autosomal dominant inheritance (HP:0000006): A mode of inheritance that is observed for traits related to a gene encoded on one of the autosomes (i.e., the human chromosomes 1-22) in which a trait manifests in heterozygotes. In the context of medical genetics, an autosomal dominant disorder is caused when a single copy of the mutant allele is present. Males and females are affected equally, and can both transmit the disorder with a risk of 50% for each child of inheriting the mutant allele. Evidence: PCS. (PMID:20960469)
- Hydronephrosis (HP:0000126): Severe distention of the kidney with dilation of the renal pelvis and calices. Evidence: PCS. Frequency: 2/4. (PMID:20960469)
These phenotypes are associated with the disease vesicoureteral reflux 3 (OMIM:613674).